Phenotypes associated with the disease Ringed hair disease (ORPHA:169):
- Fine hair (HP:0002213): Hair that is fine or thin to the touch. Evidence: TAS. Frequency: Very frequent (HP:0040281). (ORPHA:169)
- Abnormal hair pattern (HP:0010720): An abnormality of the distribution of hair growth. Evidence: TAS. Frequency: Very frequent (HP:0040281). (ORPHA:169)